- Female infertility (HP:0008222). Evidence: PCS. Frequency: 3/3. (PMID:30877238)
- Young adult onset (HP:0011462): Onset of disease at the age of between 16 and 40 years. Evidence: PCS. Frequency: 3/3. (PMID:30877238)
- Autosomal recessive inheritance (HP:0000007): A mode of inheritance that is observed for traits related to a gene encoded on one of the autosomes (i.e., the human chromosomes 1-22) in which a trait manifests in individuals with two pathogenic alleles, either homozygotes (two copies of the same mutant allele) or compound heterozygotes (whereby each copy of a gene has a distinct mutant allele). Evidence: PCS. (PMID:30877238)
These phenotypes are associated with the disease oocyte/zygote/embryo maturation arrest 19 (OMIM:620333).